Phenotypes associated with the disease retinitis pigmentosa 25 (OMIM:602772):
- Constriction of peripheral visual field (HP:0001133): An absolute or relative decrease in retinal sensitivity extending from edge (periphery) of the visual field in a concentric pattern. The visual field is the area that is perceived simultaneously by a fixating eye. Evidence: PCS. (PMID:18976725)
- Undetectable electroretinogram (HP:0000550): Lack of any response to stimulation upon electroretinography. Evidence: PCS. (PMID:18976725)
- Spicular pigmentation of the retina (HP:0007737): Pigment migration into the retina in a bone-spicule configuration (resembling the nucleated cells within the lacuna of bone). Evidence: PCS. (PMID:18976725)
- Nyctalopia (HP:0000662): Inability to see well at night or in poor light. Evidence: PCS. (PMID:18976725)
- Photophobia (HP:0000613): Excessive sensitivity to light with the sensation of discomfort or pain in the eyes due to exposure to bright light. Evidence: IEA. (OMIM:602772)
- Autosomal recessive inheritance (HP:0000007): A mode of inheritance that is observed for traits related to a gene encoded on one of the autosomes (i.e., the human chromosomes 1-22) in which a trait manifests in individuals with two pathogenic alleles, either homozygotes (two copies of the same mutant allele) or compound heterozygotes (whereby each copy of a gene has a distinct mutant allele). Evidence: PCS. (PMID:18976725)
- Rod-cone dystrophy (HP:0000510): An inherited retinal disease subtype in which the rod photoreceptors appear to be more severely affected than the cone photoreceptors. Typical presentation is with nyctalopia (due to rod dysfunction) followed by loss of mid-peripheral field of vision, which gradually extends and leaves many patients with a small central island of vision due to the preservation of macular cones. Evidence: PCS. (PMID:18976725)
- Optic disc pallor (HP:0000543): A pale yellow discoloration of the optic disc (the area of the optic nerve head in the retina). The optic disc normally has a pinkish hue with a central yellowish depression. Evidence: IEA. (OMIM:602772)
- Posterior subcapsular cataract (HP:0007787): A type of cataract affecting the posterior pole of lens immediately adjacent to ('beneath') the Lens capsule. Evidence: IEA. Frequency: Very rare (HP:0040284). (OMIM:602772)
- Attenuation of retinal blood vessels (HP:0007843): Narrowing of the retinal blood vessels, both arterioles and venules. Evidence: PCS. (PMID:18976725)
- Chorioretinal atrophy (HP:0000533): Atrophy (wasting) of the choroid and retinal layers of the fundus. Evidence: IEA. Frequency: Very rare (HP:0040284). (OMIM:602772)